Phenotypes associated with the disease Fixed subaortic stenosis (ORPHA:3092):
- Abnormal heart morphology (HP:0001627): Any structural anomaly of the heart. Evidence: TAS. Frequency: Frequent (HP:0040282). (ORPHA:3092)
- Ventricular septal defect (HP:0001629): A hole between the two bottom chambers (ventricles) of the heart. The defect is centered around the most superior aspect of the ventricular septum. Evidence: TAS. Frequency: Frequent (HP:0040282). (ORPHA:3092)
- Congestive heart failure (HP:0001635): The presence of an abnormality of cardiac function that is responsible for the failure of the heart to pump blood at a rate that is commensurate with the needs of the tissues or a state in which abnormally elevated filling pressures are required for the heart to do so. Heart failure is frequently related to a defect in myocardial contraction. Evidence: TAS. Frequency: Frequent (HP:0040282). (ORPHA:3092)
- Patent ductus arteriosus (HP:0001643): In utero, the ductus arteriosus (DA) serves to divert ventricular output away from the lungs and toward the placenta by connecting the main pulmonary artery to the descending aorta. A patent ductus arteriosus (PDA) in the first 3 days of life is a physiologic shunt in healthy term and preterm newborn infants, and normally is substantially closed within about 24 hours after bith and completely closed after about three weeks. Failure of physiologcal closure is referred to a persistent or patent ductus arteriosus (PDA). Depending on the degree of left-to-right shunting, PDA can have clinical consequences. Evidence: TAS. Frequency: Frequent (HP:0040282). (ORPHA:3092)
- Aortic regurgitation (HP:0001659): An insufficiency of the aortic valve, leading to regurgitation (backward flow) of blood from the aorta into the left ventricle. Evidence: TAS. Frequency: Frequent (HP:0040282). (ORPHA:3092)
- Left ventricular hypertrophy (HP:0001712): Enlargement or increased size of the heart left ventricle. Evidence: TAS. Frequency: Frequent (HP:0040282). (ORPHA:3092)
- Dyspnea (HP:0002094): Difficult or labored breathing. Dyspnea is a subjective feeling only the patient can rate, e.g., on a Borg scale. Evidence: TAS. Frequency: Frequent (HP:0040282). (ORPHA:3092)
- Exertional dyspnea (HP:0002875): Perceived difficulty to breathe that occurs with exercise or exertion and improves with rest. Evidence: TAS. Frequency: Frequent (HP:0040282). (ORPHA:3092)
- Systolic heart murmur (HP:0031664): A heart murmur limited to systole, i.e., between the first and second heart sounds S1 and S2. Evidence: TAS. Frequency: Frequent (HP:0040282). (ORPHA:3092)
- Diastolic heart murmur (HP:0031668): A heart murmur that occurs during diastole, i.e., in the time between S2 and the subsequent S1. Evidence: TAS. Frequency: Frequent (HP:0040282). (ORPHA:3092)
- Left ventricular outflow tract obstruction (HP:0032092): Left ventricular outflow tract (LVOT) obstruction can occur at the valvular, subvalvular, or supravalvular level. In general, there is an obstruction to forward flow which increases afterload, and if untreated, can result in hypertrophy, dilatation, and eventual failure of the left ventricle. Evidence: TAS. Frequency: Frequent (HP:0040282). (ORPHA:3092)
- Syncope (HP:0001279): A transient loss of consciousness (i.e., characterized by a rapid onset, a short duration, and a spontaneous and complete recovery) due to cerebral hypoperfusion. Evidence: TAS. Frequency: Occasional (HP:0040283). (ORPHA:3092)
- Cardiomegaly (HP:0001640): Increased size of the heart, clinically defined as an increased transverse diameter of the cardiac silhouette that is greater than or equal to 50% of the transverse diameter of the chest (increased cardiothoracic ratio) on a posterior-anterior projection of a chest radiograph or a computed tomography. Evidence: TAS. Frequency: Occasional (HP:0040283). (ORPHA:3092)
- Pulmonic stenosis (HP:0001642): A narrowing of the right ventricular outflow tract that can occur at the pulmonary valve (valvular stenosis), below the pulmonary valve (infundibular stenosis), or above the pulmonary valve (supravalvar stenosis). Evidence: TAS. Frequency: Occasional (HP:0040283). (ORPHA:3092)
- Bicuspid aortic valve (HP:0001647): The presence of an aortic valve with two instead of the normal three cusps (flaps). Bicuspid aortic valvue is a malformation of a commissure (small space between the attachment of each cusp to the aortic wall) and the adjacent parts of the two corresponding cusps forming a raphe (the fused area of the two underdeveloped cusps turning into a malformed commissure between both cusps; the raphe is a fibrous ridge that extends from the commissure to the free edge of the two underdeveloped, conjoint cusps). Evidence: TAS. Frequency: Occasional (HP:0040283). (ORPHA:3092)
- Mitral regurgitation (HP:0001653): An abnormality of the mitral valve characterized by insufficiency or incompetence of the mitral valve resulting in retrograde leaking of blood through the mitral valve upon ventricular contraction. Evidence: TAS. Frequency: Occasional (HP:0040283). (ORPHA:3092)
- Abnormal cardiac septum morphology (HP:0001671): An anomaly of the intra-atrial or intraventricular septum. Evidence: TAS. Frequency: Occasional (HP:0040283). (ORPHA:3092)
- Coarctation of aorta (HP:0001680): Coarctation of the aorta is a narrowing or constriction of a segment of the aorta. Evidence: TAS. Frequency: Occasional (HP:0040283). (ORPHA:3092)
- Angina pectoris (HP:0001681): Paroxysmal chest pain that occurs with exertion or stress and is related to myocardial ischemia. Evidence: TAS. Frequency: Occasional (HP:0040283). (ORPHA:3092)
- Palpitations (HP:0001962): A sensation that the heart is pounding or racing, which is a non-specific sign but may be a manifestation of arrhythmia. Evidence: TAS. Frequency: Occasional (HP:0040283). (ORPHA:3092)
- Paroxysmal atrial fibrillation (HP:0004757): Episodes of atrial fibrillation that typically last for several hours up to one day and terminate spontaneously. Evidence: TAS. Frequency: Occasional (HP:0040283). (ORPHA:3092)
- Ascending tubular aorta aneurysm (HP:0004970): An abnormal localized widening (dilatation) of the tubular part of the ascending aorta. Evidence: TAS. Frequency: Occasional (HP:0040283). (ORPHA:3092)
- Bacterial endocarditis (HP:0006689): A bacterial infection of the endocardium, the inner layer of the heart, which usually involves the heart valves. Evidence: TAS. Frequency: Occasional (HP:0040283). (ORPHA:3092)
- Atrioventricular canal defect (HP:0006695): A defect of the atrioventricular septum of the heart. Evidence: TAS. Frequency: Occasional (HP:0040283). (ORPHA:3092)
- Orthopnea (HP:0012764): A sensation of breathlessness in the recumbent position, relieved by sitting or standing. Evidence: TAS. Frequency: Occasional (HP:0040283). (ORPHA:3092)
- Pulmonary venous hypertension (HP:0030950): An abnormal increase in pressure in the pulmonary veins, usually as a result of left atrial hypertension. Evidence: TAS. Frequency: Occasional (HP:0040283). (ORPHA:3092)
- Postexertional symptom exacerbation (HP:0030973): Post-exertional symptom exacerbation (PESE), also referred to as post-exertional malaise (PEM), is defined as the worsening of symptoms that can follow minimal cognitive, physical, emotional, or social activity, or activity that could previously be tolerated. Symptoms typically worsen 12 to 72 hours after activity and can last for days or even weeks, sometimes leading to a relapse. Evidence: TAS. Frequency: Occasional (HP:0040283). (ORPHA:3092)
- Chest pain (HP:0100749): An unpleasant sensation characterized by physical discomfort (such as pricking, throbbing, or aching) localized to the chest. Evidence: TAS. Frequency: Occasional (HP:0040283). (ORPHA:3092)